Phenotypes associated with the disease Palmoplantar keratoderma-XX sex reversal-predisposition to squamous cell carcinoma syndrome (ORPHA:85112):
- Palmoplantar keratoderma (HP:0000982): Abnormal thickening of the skin of the palms of the hands and the soles of the feet. Evidence: TAS. Frequency: Very frequent (HP:0040281). (ORPHA:85112)
- Squamous cell carcinoma of the skin (HP:0006739): Squamous cell carcinoma of the skin is a malignant tumor of squamous epithelium. Evidence: TAS. Frequency: Very frequent (HP:0040281). (ORPHA:85112)
- Sex reversal (HP:0012245): Development of the reproductive system is inconsistent with the chromosomal sex. Evidence: TAS. Frequency: Very frequent (HP:0040281). (ORPHA:85112)